- Microcephaly (HP:0000252): Head circumference below 2 standard deviations below the mean for age and gender. Evidence: TAS. Frequency: Frequent (HP:0040282). (ORPHA:1711)
- Microretrognathia (HP:0000308): A form of developmental hypoplasia of the mandible in which the mandible is mislocalised posteriorly. Evidence: TAS. Frequency: Frequent (HP:0040282). (ORPHA:1711)
- Hypertelorism (HP:0000316): Interpupillary distance more than 2 SD above the mean (alternatively, the appearance of an increased interpupillary distance or widely spaced eyes). Evidence: TAS. Frequency: Frequent (HP:0040282). (ORPHA:1711)
- Hearing impairment (HP:0000365): A decreased magnitude of the sensory perception of sound. Evidence: TAS. Frequency: Frequent (HP:0040282). (ORPHA:1711)
- Delayed speech and language development (HP:0000750): A degree of language development that is significantly below the norm for a child of a specified age. Evidence: TAS. Frequency: Frequent (HP:0040282). (ORPHA:1711)
- Single umbilical artery (HP:0001195): Single umbilical artery (SUA) is the absence of one of the two umbilical arteries surrounding the fetal bladder and in the fetal umbilical cord. Evidence: TAS. Frequency: Frequent (HP:0040282). (ORPHA:1711)
- Intellectual disability (HP:0001249): The term intellectual disability or intellectual developmental disorder is used to describe significantly sub-average intellectual and adaptive functioning based on clinical assessment and as measured by individually administered, appropriately normed, standardized and validated tests of intellectual functioning and adaptive behavior, with onset during the developmental period from infancy through adolescence. Evidence: TAS. Frequency: Frequent (HP:0040282). (ORPHA:1711)
- Seizure (HP:0001250): A seizure is an intermittent abnormality of nervous system physiology characterized by a transient occurrence of signs and/or symptoms due to abnormal excessive or synchronous neuronal activity in the brain. Evidence: TAS. Frequency: Frequent (HP:0040282). (ORPHA:1711)
- Hypotonia (HP:0001252): Hypotonia is an abnormally low muscle tone (the amount of tension or resistance to movement in a muscle). Even when relaxed, muscles have a continuous and passive partial contraction which provides some resistance to passive stretching. Hypotonia thus manifests as diminished resistance to passive stretching. Hypotonia is not the same as muscle weakness, although the two conditions can co-exist. Evidence: TAS. Frequency: Frequent (HP:0040282). (ORPHA:1711)
- Global developmental delay (HP:0001263): A delay in the achievement of motor or mental milestones in the domains of development of a child, including motor skills, speech and language, cognitive skills, and social and emotional skills. This term should only be used to describe children younger than five years of age. Evidence: TAS. Frequency: Frequent (HP:0040282). (ORPHA:1711)
- Cerebellar hypoplasia (HP:0001321): Cerebellar hypoplasia is a descriptive term implying a cerebellum with a reduced volume, but a normal shape and is stable over time. Evidence: TAS. Frequency: Frequent (HP:0040282). (ORPHA:1711)
- Intrauterine growth retardation (HP:0001511): An abnormal restriction of fetal growth with fetal weight below the tenth percentile for gestational age. Evidence: TAS. Frequency: Frequent (HP:0040282). (ORPHA:1711)
- Ventricular septal defect (HP:0001629): A hole between the two bottom chambers (ventricles) of the heart. The defect is centered around the most superior aspect of the ventricular septum. Evidence: TAS. Frequency: Frequent (HP:0040282). (ORPHA:1711)
- Attention deficit hyperactivity disorder (HP:0007018): Attention deficit hyperactivity disorder (ADHD) manifests at age 2-3 years or by first grade at the latest. The main symptoms are distractibility, impulsivity, hyperactivity, and often trouble organizing tasks and projects, difficulty going to sleep, and social problems from being aggressive, loud, or impatient. Evidence: TAS. Frequency: Frequent (HP:0040282). (ORPHA:1711)
- Postnatal growth retardation (HP:0008897): Slow or limited growth after birth. Evidence: TAS. Frequency: Frequent (HP:0040282). (ORPHA:1711)
- Inguinal hernia (HP:0000023): Protrusion of the contents of the abdominal cavity through the inguinal canal. Evidence: TAS. Frequency: Occasional (HP:0040283). (ORPHA:1711)
- Cystic hygroma (HP:0000476): A cystic lymphatic lesion of the neck. Evidence: TAS. Frequency: Occasional (HP:0040283). (ORPHA:1711)
- Ventriculomegaly (HP:0002119): An increase in size of the ventricular system of the brain. Evidence: TAS. Frequency: Occasional (HP:0040283). (ORPHA:1711)
- Scoliosis (HP:0002650): The presence of an abnormal lateral curvature of the spine. Evidence: TAS. Frequency: Occasional (HP:0040283). (ORPHA:1711)
- Lower limb asymmetry (HP:0100559): A difference in length or diameter between the left and right leg. Evidence: TAS. Frequency: Occasional (HP:0040283). (ORPHA:1711)
These phenotypes are associated with the disease Mosaic trisomy 17 syndrome (ORPHA:1711).